Phenotypes associated with the disease Catifa syndrome (OMIM:618761):
- Epicanthus (HP:0000286): A fold of skin starting above the medial aspect of the upper eyelid and arching downward to cover, pass in front of and lateral to the medial canthus. Evidence: PCS. Frequency: 4/8. (PMID:31932796)
- Tooth malposition (HP:0000692): Abnormal alignment, positioning, or spacing of the teeth, i.e., misaligned teeth. Evidence: PCS. Frequency: 4/8. (PMID:31932796)
- Cleft palate (HP:0000175): Cleft palate is a developmental defect of the palate resulting from a failure of fusion of the palatine processes and manifesting as a separation of the roof of the mouth (soft and hard palate). Evidence: PCS. Frequency: 3/8. (PMID:31932796)
- Delayed eruption of teeth (HP:0000684): Delayed tooth eruption, which can be defined as tooth eruption more than 2 SD beyond the mean eruption age. Evidence: PCS. Frequency: 3/8. (PMID:31932796)
- Strabismus (HP:0000486): A misalignment of the eyes so that the visual axes deviate from bifoveal fixation. The classification of strabismus may be based on a number of features including the relative position of the eyes, whether the deviation is latent or manifest, intermittent or constant, concomitant or otherwise and according to the age of onset and the relevance of any associated refractive error. Evidence: PCS. Frequency: 5/8. (PMID:31932796)
- Long philtrum (HP:0000343): Distance between nasal base and midline upper lip vermilion border more than 2 SD above the mean. Alternatively, an apparently increased distance between nasal base and midline upper lip vermilion border. Evidence: PCS. Frequency: 3/8. (PMID:31932796)
- Inguinal hernia (HP:0000023): Protrusion of the contents of the abdominal cavity through the inguinal canal. Evidence: PCS. Frequency: 2/8. (PMID:31932796)
- Gait disturbance (HP:0001288): The term gait disturbance can refer to any disruption of the ability to walk. Evidence: PCS. Frequency: 8/8. (PMID:31932796)
- Long face (HP:0000276): Facial height (length) is more than 2 standard deviations above the mean (objective); or, an apparent increase in the height (length) of the face (subjective). Evidence: PCS. Frequency: 6/8. (PMID:31932796)
- Anteverted nares (HP:0000463): Anteriorly-facing nostrils viewed with the head in the Frankfurt horizontal and the eyes of the observer level with the eyes of the subject. This gives the appearance of an upturned nose (upturned nasal tip). Evidence: PCS. Frequency: 5/8. (PMID:31932796)
- Asthma (HP:0002099): Asthma is characterized by increased responsiveness of the tracheobronchial tree to multiple stimuli, leading to narrowing of the air passages with resultant dyspnea, cough, and wheezing. Evidence: PCS. Frequency: 5/8. (PMID:31932796)
- Global developmental delay (HP:0001263): A delay in the achievement of motor or mental milestones in the domains of development of a child, including motor skills, speech and language, cognitive skills, and social and emotional skills. This term should only be used to describe children younger than five years of age. Evidence: PCS. Frequency: 10/10. (PMID:27878435;PMID:31932796)
- Sleep disturbance (HP:0002360): An abnormal pattern in the quality, quantity, or characteristics of sleep. Evidence: PCS. Frequency: 3/8. (PMID:31932796)
- Cleft lip (HP:0410030): A gap in the lip or lips. Evidence: PCS. Frequency: 5/8. (PMID:31932796)
- Mild microcephaly (HP:0040196): Decreased occipito-frontal (head) circumference (OFC). For the microcephaly OFC must be between -3 SD and -2 SD compared to appropriate, age matched, normal standards (i.e. -3 SD <= OFC < -2 SD). Evidence: PCS. Frequency: 4/8. (PMID:31932796)
- Camptodactyly (HP:0012385): The distal interphalangeal joint and/or the proximal interphalangeal joint of the fingers or toes cannot be extended to 180 degrees by either active or passive extension. Evidence: PCS. Frequency: 1/8. (PMID:31932796)
- Increased overbite (HP:0011094): Maxillary teeth cover the mandibular teeth when biting to an increased degree. The feature is defined as a vertical overlap of the maxillary incisors over the mandibular incisors that exceeds 2 mm. Evidence: PCS. Frequency: 2/8. (PMID:31932796)
- Developmental cataract (HP:0000519): A cataract that occurs congenitally as the result of a developmental defect, in contrast to the majority of cataracts that occur in adulthood as the result of degenerative changes of the lens. Evidence: PCS. Frequency: 2/2. Onset: Congenital onset (HP:0003577). (PMID:27878435)
- Developmental cataract (HP:0000519): A cataract that occurs congenitally as the result of a developmental defect, in contrast to the majority of cataracts that occur in adulthood as the result of degenerative changes of the lens. Evidence: PCS. Frequency: 7/8. (PMID:31932796)
- Microtia (HP:0008551): Underdevelopment of the external ear. Evidence: PCS. Frequency: 5/8. (PMID:31932796)
- Amblyopia (HP:0000646): Reduced visual acuity that is uncorrectable by lenses in the absence of detectable anatomic defects in the eye or visual pathways. Evidence: PCS. Frequency: 3/8. (PMID:31932796)
- Autosomal recessive inheritance (HP:0000007): A mode of inheritance that is observed for traits related to a gene encoded on one of the autosomes (i.e., the human chromosomes 1-22) in which a trait manifests in individuals with two pathogenic alleles, either homozygotes (two copies of the same mutant allele) or compound heterozygotes (whereby each copy of a gene has a distinct mutant allele). Evidence: PCS. (PMID:27878435)
- Attention deficit hyperactivity disorder (HP:0007018): Attention deficit hyperactivity disorder (ADHD) manifests at age 2-3 years or by first grade at the latest. The main symptoms are distractibility, impulsivity, hyperactivity, and often trouble organizing tasks and projects, difficulty going to sleep, and social problems from being aggressive, loud, or impatient. Evidence: PCS. Frequency: 7/8. (PMID:31932796)
- Intellectual disability (HP:0001249): The term intellectual disability or intellectual developmental disorder is used to describe significantly sub-average intellectual and adaptive functioning based on clinical assessment and as measured by individually administered, appropriately normed, standardized and validated tests of intellectual functioning and adaptive behavior, with onset during the developmental period from infancy through adolescence. Evidence: PCS. Frequency: 8/8. (PMID:31932796)